- Abnormality of the nervous system (HP:0000707): An abnormality of the nervous system. Evidence: TAS. Frequency: Very frequent (HP:0040281). (ORPHA:1560)
- Seizure (HP:0001250): A seizure is an intermittent abnormality of nervous system physiology characterized by a transient occurrence of signs and/or symptoms due to abnormal excessive or synchronous neuronal activity in the brain. Evidence: TAS. Frequency: Frequent (HP:0040282). (ORPHA:1560)
- Cerebral calcification (HP:0002514): The presence of calcium deposition within the cerebrum. Evidence: TAS. Frequency: Frequent (HP:0040282). (ORPHA:1560)
- Increased CSF protein concentration (HP:0002922): Increased concentration of protein in the cerebrospinal fluid. Evidence: TAS. Frequency: Frequent (HP:0040282). (ORPHA:1560)
- Somatic sensory dysfunction (HP:0003474): An abnormality of the primary sensation that is mediated by peripheral nerves (pain, temperature, touch, vibration, joint position). The word hypoesthesia (or hypesthesia) refers to a reduction in cutaneous sensation to a specific type of testing. Evidence: TAS. Frequency: Frequent (HP:0040282). (ORPHA:1560)
- Functional motor deficit (HP:0004302). Evidence: TAS. Frequency: Frequent (HP:0040282). (ORPHA:1560)
- Intracranial cystic lesion (HP:0010576): A cystic lesion originating within the brain. Evidence: TAS. Frequency: Frequent (HP:0040282). (ORPHA:1560)
- Abnormal meningeal morphology (HP:0010651): An abnormality of the Meninges, including any abnormality of the Dura mater, the Arachnoid mater, and the Pia mater. Evidence: TAS. Frequency: Frequent (HP:0040282). (ORPHA:1560)
- Increased circulating immunoglobulin concentration (HP:0010702): An increased level of gamma globulin (immunoglobulin) in the blood. Evidence: TAS. Frequency: Frequent (HP:0040282). (ORPHA:1560)
- Abnormal skeletal muscle morphology (HP:0011805): A structural abnormality of a skeletal muscle. Evidence: TAS. Frequency: Frequent (HP:0040282). (ORPHA:1560)
- Abnormal brain morphology (HP:0012443): A structural abnormality of the brain, which has as its parts the forebrain, midbrain, and hindbrain. Evidence: TAS. Frequency: Frequent (HP:0040282). (ORPHA:1560)
- Abnormal subarachnoid space morphology (HP:0012703): Abnormality in the space in the meninges beneath the arachnoid membrane and above the pia mater that contains the cerebrospinal fluid. Evidence: TAS. Frequency: Frequent (HP:0040282). (ORPHA:1560)
- Arachnoid cyst (HP:0100702): An extra-parenchymal and intra-arachnoidal collection of fluid with a composition similar to that of cerebrospinal fluid. Evidence: TAS. Frequency: Frequent (HP:0040282). (ORPHA:1560)
- CSF lymphocytic pleiocytosis (HP:0200149): An increased lymphocyte count in the cerebrospinal fluid. Evidence: TAS. Frequency: Frequent (HP:0040282). (ORPHA:1560)
- Increased anti-parasite IgE antibody level (HP:0410234): Increased level of IgE antibody against parasites, such as helminths (parasitic worms, such as Ascaris lumbricoides, Trichuris trichiura, Ancylostoma duodenalis, Necator americanus, Strongyloides stercoralis) or parasites such as Toxoplasma gondii. Evidence: TAS. Frequency: Frequent (HP:0040282). (ORPHA:1560)
- Diplopia (HP:0000651): Diplopia is a condition in which a single object is perceived as two images, it is also known as double vision. Evidence: TAS. Frequency: Occasional (HP:0040283). (ORPHA:1560)
- Atypical behavior (HP:0000708): Atypical behavior is an abnormality in a person's actions that can be controlled or modulated by the will of the individual. While abnormal behaviors can be difficult to control, they are distinct from other abnormal actions that cannot be affected by the individual's will. Evidence: TAS. Frequency: Occasional (HP:0040283). (ORPHA:1560)
- Emotional lability (HP:0000712): Unstable emotional experiences and frequent mood changes; emotions that are easily aroused, intense, and/or disproportionate to events and circumstances. Evidence: TAS. Frequency: Occasional (HP:0040283). (ORPHA:1560)
- Hallucinations (HP:0000738): Perceptions in a conscious and awake state that, in the absence of external stimuli, have qualities of real perception. These perceptions are vivid, substantial, and located in external objective space. Evidence: TAS. Frequency: Occasional (HP:0040283). (ORPHA:1560)
- Abnormality of the vertebral column (HP:0000925): Any abnormality of the vertebral column. Evidence: TAS. Frequency: Occasional (HP:0040283). (ORPHA:1560)
- Abnormal skull morphology (HP:0000929): An abnormality of the skull, the bony framework of the head which is comprised of the neurocranium (with eight cranial bones) and the viscerocranium (facial skeleton) that comprises fourteen facial bones with the mandible as its largest bone. Evidence: TAS. Frequency: Occasional (HP:0040283). (ORPHA:1560)
- Posterior fossa cyst at the fourth ventricle (HP:0000933). Evidence: TAS. Frequency: Occasional (HP:0040283). (ORPHA:1560)
- Abnormal myocardium morphology (HP:0001637): A structural anomaly of the muscle layer of the heart wall. Evidence: TAS. Frequency: Occasional (HP:0040283). (ORPHA:1560)
- Status epilepticus (HP:0002133): Status epilepticus is a type of prolonged seizure resulting either from the failure of the mechanisms responsible for seizure termination or from the initiation of mechanisms which lead to abnormally prolonged seizures (after time point t1). It is a condition that can have long-term consequences (after time point t2), including neuronal death, neuronal injury, and alteration of neuronal networks, depending on the type and duration of seizures. Evidence: TAS. Frequency: Occasional (HP:0040283). (ORPHA:1560)
- Generalized-onset seizure (HP:0002197): A generalized-onset seizure is a type of seizure originating at some point within, and rapidly engaging, bilaterally distributed networks. The networks may include cortical and subcortical structures but not necessarily the entire cortex. Evidence: TAS. Frequency: Occasional (HP:0040283). (ORPHA:1560)
- Memory impairment (HP:0002354): An impairment of memory as manifested by a reduced ability to remember things such as dates and names, and increased forgetfulness. Evidence: TAS. Frequency: Occasional (HP:0040283). (ORPHA:1560)
- Upper motor neuron dysfunction (HP:0002493): A functional anomaly of the upper motor neuron. The upper motor neurons are neurons of the primary motor cortex which project to the brainstem and spinal chord via the corticonuclear, corticobulbar and corticospinal (pyramidal) tracts. They are involved in control of voluntary movements. Dysfunction leads to weakness, impairment of fine motor movements, spasticity, hyperreflexia and abnormal pyramidal signs. Evidence: TAS. Frequency: Occasional (HP:0040283). (ORPHA:1560)
- Increased intracranial pressure (HP:0002516): An increase of the pressure inside the cranium (skull) and thereby in the brain tissue and cerebrospinal fluid. Evidence: TAS. Frequency: Occasional (HP:0040283). (ORPHA:1560)
- Cranial nerve paralysis (HP:0006824). Evidence: TAS. Frequency: Occasional (HP:0040283). (ORPHA:1560)
- Focal-onset seizure (HP:0007359): A focal-onset seizure is a type of seizure originating within networks limited to one hemisphere. They may be discretely localized or more widely distributed, and may originate in subcortical structures. Evidence: TAS. Frequency: Occasional (HP:0040283). (ORPHA:1560)
- Spinal arachnoid cyst (HP:0009745): Presence of arachnoid cysts of the spinal canal extradurally in the epidural space. Evidence: TAS. Frequency: Occasional (HP:0040283). (ORPHA:1560)
- Abnormal eye morphology (HP:0012372): A structural anomaly of the globe of the eye, or bulbus oculi. Evidence: TAS. Frequency: Occasional (HP:0040283). (ORPHA:1560)
- Stiff neck (HP:0025258): A sensation of tightness in the neck when attempting to move it, especially after a period of inactivity. Neck stiffness often involves soreness and difficulty moving the neck, especially when trying to turn the head to the side. Evidence: TAS. Frequency: Occasional (HP:0040283). (ORPHA:1560)
- Calcification of muscles (HP:0100249): Deposition of calcium salts in muscle tissue. Evidence: TAS. Frequency: Occasional (HP:0040283). (ORPHA:1560)
- Spinal cord lesion (HP:0100561). Evidence: TAS. Frequency: Occasional (HP:0040283). (ORPHA:1560)
- Retinal detachment (HP:0000541): Separation of the inner layers of the retina (neural retina) from the pigment epithelium. Evidence: TAS. Frequency: Very rare (HP:0040284). (ORPHA:1560)
- Dementia (HP:0000726): A loss of global cognitive ability of sufficient amount to interfere with normal social or occupational function. Dementia represents a loss of previously present cognitive abilities, generally in adults, and can affect memory, thinking, language, judgment, and behavior. Evidence: TAS. Frequency: Very rare (HP:0040284). (ORPHA:1560)
- Apathy (HP:0000741): Apathy is a quantitative reduction of interest, motivation and the initiation and persistence of goal-directed behavior, where often the accompanying emotions, thoughts, and social interactions are also diminished. The individual is typically non-reactive to provocations, positive or negative, and appears to not care. Distinguished from lethargy which involves lack of physical or mental energy. Evidence: TAS. Frequency: Very rare (HP:0040284). (ORPHA:1560)
- Iridocyclitis (HP:0001094): A type of anterior uveitis, in which there is Inflammation of the iris and the ciliary body. Evidence: TAS. Frequency: Very rare (HP:0040284). (ORPHA:1560)
- Ataxia (HP:0001251): Ataxia refers to impaired coordination of voluntary muscle movement. Cerebellar ataxia refers to ataxia due to dysfunction of the cerebellum. This causes a variety of elementary neurological deficits including asynergy (lack of coordination between muscles, limbs and joints), dysmetria (lack of ability to judge distances that can lead to under- or overshoot in grasping movements), and dysdiadochokinesia (inability to perform rapid movements requiring antagonizing muscle groups to be switched on and off repeatedly). Evidence: TAS. Frequency: Very rare (HP:0040284). (ORPHA:1560)
- Dysarthria (HP:0001260): Dysarthric speech is a general description referring to a neurological speech disorder characterized by poor articulation. Depending on the involved neurological structures, dysarthria may be further classified as spastic, flaccid, ataxic, hyperkinetic and hypokinetic, or mixed. Evidence: TAS. Frequency: Very rare (HP:0040284). (ORPHA:1560)
- Mental deterioration (HP:0001268): Loss of previously present mental abilities, generally in adults. Evidence: TAS. Frequency: Very rare (HP:0040284). (ORPHA:1560)
- Confusion (HP:0001289): Lack of clarity and coherence of thought, perception, understanding, or action. Evidence: TAS. Frequency: Very rare (HP:0040284). (ORPHA:1560)
- Stroke (HP:0001297): Sudden impairment of blood flow to a part of the brain due to occlusion or rupture of an artery to the brain. Evidence: TAS. Frequency: Very rare (HP:0040284). (ORPHA:1560)
- Infectious encephalitis (HP:0002383): A disorder of the brain caused by an infectious agent that presents with fever, headache, and an altered level of consciousness. There may also be focal or multifocal neurologic deficits, and focal or generalized seizure activity. Evidence: TAS. Frequency: Very rare (HP:0040284). (ORPHA:1560)
- Arterial thrombosis (HP:0004420): The formation of a blood clot inside an artery. Evidence: TAS. Frequency: Very rare (HP:0040284). (ORPHA:1560)
- Loss of consciousness (HP:0007185): Loss of awareness of oneself or one's surroundings, involving (i) a loss of normal motor control is evident as flaccidity or stiffness, either of which can be accompanied by jerking movements, and postural control is lost so that patients fall if they are in an upright position; (ii) normal responsiveness is lost; and (iii) the patient experiences amnesia for the event. Loss of consciousness my be transitory (e.g., syncope) or prolonged. Evidence: TAS. Frequency: Very rare (HP:0040284). (ORPHA:1560)
- Chorioretinitis (HP:0012424): An inflammation of the choroid and retina. Evidence: TAS. Frequency: Very rare (HP:0040284). (ORPHA:1560)
- Abnormal optic chiasm morphology (HP:0025163): A structural abnormality of the optic chiasm.The optic chiasm, located below the hypothalamus, is a partial crossing of the optic nerves. Evidence: TAS. Frequency: Very rare (HP:0040284). (ORPHA:1560)
These phenotypes are associated with the disease Cysticercosis (ORPHA:1560).